- Orofacial cleft (HP:0000202): The presence of a cleft (gap, opening, or groove) in the oral cavity, including cleft of the upper lip and/or cleft of the palate. Cleft of the upper lip is visible as a groove or fissure in the lip, most frequently due to a congenital failure of the maxillary and median nasal processes to fuse. Cleft palate is characterized by a grooved depression or fissure in the roof of the mouth, most often resulting from a congenital failure of the palate to fuse properly. Clefts of the lip and palate can occur individually or together. It is preferable to code each defect separately. Evidence: TAS. Frequency: Very frequent (HP:0040281). (ORPHA:2328)
- Posteriorly rotated ears (HP:0000358): A type of abnormal location of the ears in which the position of the ears is characterized by posterior rotation (the superior part of the ears is rotated towards the back of the head, and the inferior part of the ears towards the front). Evidence: TAS. Frequency: Very frequent (HP:0040281). (ORPHA:2328)
- Low-set ears (HP:0000369): Upper insertion of the ear to the scalp below an imaginary horizontal line drawn between the inner canthi of the eye and extending posteriorly to the ear. Evidence: TAS. Frequency: Very frequent (HP:0040281). (ORPHA:2328)
- Bulbous nose (HP:0000414): Increased volume and globular shape of the anteroinferior aspect of the nose. Evidence: TAS. Frequency: Very frequent (HP:0040281). (ORPHA:2328)
- Retinal coloboma (HP:0000480): A notch or cleft of the retina or choroid, located vertically below the optic disc. Evidence: TAS. Frequency: Very frequent (HP:0040281). (ORPHA:2328)
- Microphthalmia (HP:0000568): A developmental anomaly characterized by abnormal smallness of one or both eyes. Evidence: TAS. Frequency: Very frequent (HP:0040281). (ORPHA:2328)
- Iris coloboma (HP:0000612): A coloboma of the iris. Evidence: TAS. Frequency: Very frequent (HP:0040281). (ORPHA:2328)
- Intellectual disability (HP:0001249): The term intellectual disability or intellectual developmental disorder is used to describe significantly sub-average intellectual and adaptive functioning based on clinical assessment and as measured by individually administered, appropriately normed, standardized and validated tests of intellectual functioning and adaptive behavior, with onset during the developmental period from infancy through adolescence. Evidence: TAS. Frequency: Very frequent (HP:0040281). (ORPHA:2328)
- Hypoplastic labia majora (HP:0000059): Undergrowth of the outer labia. Evidence: TAS. Frequency: Frequent (HP:0040282). (ORPHA:2328)
- Short neck (HP:0000470): Diminished length of the neck. Evidence: TAS. Frequency: Frequent (HP:0040282). (ORPHA:2328)
- Failure to thrive (HP:0001508): Failure to thrive (FTT) refers to a child whose physical growth is substantially below the norm. Evidence: TAS. Frequency: Frequent (HP:0040282). (ORPHA:2328)
- Constipation (HP:0002019): Infrequent or difficult evacuation of feces. Evidence: TAS. Frequency: Frequent (HP:0040282). (ORPHA:2328)
- Intestinal malrotation (HP:0002566): An abnormality of the intestinal rotation and fixation that normally occurs during the development of the gut. This can lead to volvulus, or twisting of the intestine that causes obstruction and necrosis. Evidence: TAS. Frequency: Frequent (HP:0040282). (ORPHA:2328)
- Hypoplasia of penis (HP:0008736). Evidence: TAS. Frequency: Frequent (HP:0040282). (ORPHA:2328)
- Preauricular skin tag (HP:0000384): A rudimentary tag of skin often containing ear tissue including a core of cartilage and located just anterior to the auricle (outer part of the ear). Evidence: TAS. Frequency: Occasional (HP:0040283). (ORPHA:2328)
- Atresia of the external auditory canal (HP:0000413): Absence or failure to form of the external auditory canal. Evidence: TAS. Frequency: Occasional (HP:0040283). (ORPHA:2328)
- Pachygyria (HP:0001302): Pachygyria is a malformation of cortical development with abnormally wide gyri with sulci 1,5-3 cm apart and abnormally thick cortex measuring more than 5 mm (radiological definition). See also neuropathological definitions for 2-, 3-, and 4-layered lissencephaly. Evidence: TAS. Frequency: Occasional (HP:0040283). (ORPHA:2328)
- Ventricular septal defect (HP:0001629): A hole between the two bottom chambers (ventricles) of the heart. The defect is centered around the most superior aspect of the ventricular septum. Evidence: TAS. Frequency: Occasional (HP:0040283). (ORPHA:2328)
- Tetralogy of Fallot (HP:0001636): A congenital cardiac malformation comprising pulmonary stenosis, overriding aorta, ventricular septum defect, and right ventricular hypertrophy. The diagnosis of TOF is made if at least three of the four above mentioned features are present. Evidence: TAS. Frequency: Occasional (HP:0040283). (ORPHA:2328)
- Patent ductus arteriosus (HP:0001643): In utero, the ductus arteriosus (DA) serves to divert ventricular output away from the lungs and toward the placenta by connecting the main pulmonary artery to the descending aorta. A patent ductus arteriosus (PDA) in the first 3 days of life is a physiologic shunt in healthy term and preterm newborn infants, and normally is substantially closed within about 24 hours after bith and completely closed after about three weeks. Failure of physiologcal closure is referred to a persistent or patent ductus arteriosus (PDA). Depending on the degree of left-to-right shunting, PDA can have clinical consequences. Evidence: TAS. Frequency: Occasional (HP:0040283). (ORPHA:2328)
- Polymicrogyria (HP:0002126): Polymicrogyria is a congenital malformation of the cerebral cortex characterized by abnormal cortical layering (lamination) and an excessive number of small gyri (folds). Evidence: TAS. Frequency: Occasional (HP:0040283). (ORPHA:2328)
- Dysplastic corpus callosum (HP:0006989): Dysplasia and dysgenesis of the corpus callosum are nonspecific descriptions that imply defective development of the corpus callosum. The term dysplasia is applied when the morphology of the corpus callosum is altered as a congenital trait. For instance, the corpus callosum may be hump-shaped, kinked, or a striped corpus callosum that lacks an anatomically distinct genu and splenium. Evidence: TAS. Frequency: Occasional (HP:0040283). (ORPHA:2328)
These phenotypes are associated with the disease Kapur-Toriello syndrome (ORPHA:2328).